Phenotypes associated with the disease Hypotrichosis simplex of the scalp (ORPHA:90368):
- Fine hair (HP:0002213): Hair that is fine or thin to the touch. Evidence: TAS. Frequency: Very frequent (HP:0040281). (ORPHA:90368)
- Slow-growing scalp hair (HP:0100038): Scalp hair whose growth is slower than normal. Evidence: TAS. Frequency: Very frequent (HP:0040281). (ORPHA:90368)
- Hyperkeratosis (HP:0000962): Hyperkeratosis is a histopathological term defining a thickened stratum corneum and may be present in many different skin conditions, with many possible overlaps. Hyperkeratosis refers to the increased thickness of the stratum corneum, the outer layer of the skin. Hyperkeratosis is subclassified as orthokeratotic or parakeratotic. Orthokeratotic hyperkeratosis refers to the thickening of the keratin layer with preserved keratinocyte maturation, while parakeratotic hyperkeratosis shows retained nuclei as a sign of delayed maturation of keratinocytes. Evidence: TAS. Frequency: Frequent (HP:0040282). (ORPHA:90368)
- Parakeratosis (HP:0001036): Abnormal formation of the keratinocytes of the epidermis characterized by persistence of nuclei, incomplete formation of keratin, and moistness and swelling of the keratinocytes. Evidence: TAS. Frequency: Frequent (HP:0040282). (ORPHA:90368)
- Sparse scalp hair (HP:0002209): Decreased number of hairs per unit area of skin of the scalp. Evidence: TAS. Frequency: Frequent (HP:0040282). (ORPHA:90368)
- Alopecia of scalp (HP:0002293). Evidence: TAS. Frequency: Frequent (HP:0040282). (ORPHA:90368)
- Epidermal acanthosis (HP:0025092): Diffuse hypertrophy or thickening of the stratum spinosum of the epidermis (prickle cell layer of the skin). Evidence: TAS. Frequency: Frequent (HP:0040282). (ORPHA:90368)
- Pruritus (HP:0000989): Pruritus is an itch or a sensation that makes a person want to scratch. This term refers to an abnormally increased disposition to experience pruritus. Evidence: TAS. Frequency: Occasional (HP:0040283). (ORPHA:90368)
- Atopic dermatitis (HP:0001047): Atopic dermatitis (AD) or atopic eczema is an itchy, inflammatory skin condition with a predilection for the skin flexures. It is characterized by poorly defined erythema with edema, vesicles, and weeping in the acute stage and skin thickening (lichenification) in the chronic stage. Evidence: TAS. Frequency: Occasional (HP:0040283). (ORPHA:90368)
- Allergic rhinitis (HP:0003193): It is characterized by one or more symptoms including sneezing, itching, nasal congestion, and rhinorrhea. Evidence: TAS. Frequency: Occasional (HP:0040283). (ORPHA:90368)
- Increased circulating IgE concentration (HP:0003212): An abnormally increased overall level of immunoglobulin E in blood. Evidence: TAS. Frequency: Occasional (HP:0040283). (ORPHA:90368)
- Scaling skin (HP:0040189): Refers to the loss of the outer layer of the epidermis in large, scale-like flakes. Evidence: TAS. Frequency: Occasional (HP:0040283). (ORPHA:90368)
Not associated with this disease:
- Abnormality of the dentition (HP:0000164): Any abnormality of the teeth. Evidence: TAS. (ORPHA:90368)
- Abnormal eyelash morphology (HP:0000499): An abnormality of the eyelashes. Evidence: TAS. (ORPHA:90368)
- Abnormal eyebrow morphology (HP:0000534): An abnormality of the eyebrow. Evidence: TAS. (ORPHA:90368)
- Abnormal nail morphology (HP:0001597): Abnormal structure or appearance of the nail. Evidence: TAS. (ORPHA:90368)
- Absent facial hair (HP:0002550): Absence of facial hair. Evidence: TAS. (ORPHA:90368)
- Generalized hypotrichosis (HP:0004528): Reduced or lacking hair growth in a generalized distribution. Evidence: TAS. (ORPHA:90368)
- Hypohidrosis or hyperhidrosis (HP:0007550). Evidence: TAS. (ORPHA:90368)
- Abnormality of the pubic hair (HP:0100133): Abnormality of the growth of the pubic hair. Pubic hair is part of the secondary sexual hair, which normally ensues during puberty. Evidence: TAS. (ORPHA:90368)
- Abnormality of the axillary hair (HP:0100134): Abnormality of the growth of the axillary hair. Axillary hair is part of the secondary sexual hair, which normally ensues during puberty. Evidence: TAS. (ORPHA:90368)